Phenotypes associated with the disease Double uterus-hemivagina-renal agenesis syndrome (ORPHA:3411):
- Renal agenesis (HP:0000104): Agenesis, that is, failure of the kidney to develop during embryogenesis and development. Evidence: TAS. Frequency: Very frequent (HP:0040281). (ORPHA:3411)
- Premature birth (HP:0001622): The birth of a baby of less than 37 weeks of gestational age. Evidence: TAS. Frequency: Very frequent (HP:0040281). (ORPHA:3411)
- Breech presentation (HP:0001623): A position of the fetus at delivery in which the fetus enters the birth canal with the buttocks or feet first. Evidence: TAS. Frequency: Very frequent (HP:0040281). (ORPHA:3411)
- Fever (HP:0001945): Body temperature elevated above the normal range. Evidence: TAS. Frequency: Very frequent (HP:0040281). (ORPHA:3411)
- Uterus didelphys (HP:0003762): A malformation of the uterus in which the uterus is present as a paired organ as a result of the failure of fusion of the mullerian ducts during embryogenesis. Evidence: TAS. Frequency: Very frequent (HP:0040281). (ORPHA:3411)
- Partial vaginal septum (HP:0008670). Evidence: TAS. Frequency: Very frequent (HP:0040281). (ORPHA:3411)
- Chronic pain (HP:0012532): Persistent pain, usually defined as pain that has lasted longer than 3 to 6 months. Evidence: TAS. Frequency: Very frequent (HP:0040281). (ORPHA:3411)
- Abnormal uterine cervix morphology (HP:0012888): An anomaly of the neck of the uterus (lower part of the uterus), called the uterine cervix. Evidence: TAS. Frequency: Very frequent (HP:0040281). (ORPHA:3411)
- Dyspareunia (HP:0030016): Recurrent or persistent genital pain associated with sexual intercourse. Evidence: TAS. Frequency: Very frequent (HP:0040281). (ORPHA:3411)
- Hydrocolpos (HP:0030711): Distention of the vagina caused by accumulation of fluid due to congenital vaginal obstruction. Evidence: TAS. Frequency: Very frequent (HP:0040281). (ORPHA:3411)
- Dysmenorrhea (HP:0100607): Pain during menstruation that interferes with daily activities. Evidence: TAS. Frequency: Very frequent (HP:0040281). (ORPHA:3411)
- Metrorrhagia (HP:0100608): Bleeding at irregular intervals. Evidence: TAS. Frequency: Very frequent (HP:0040281). (ORPHA:3411)